Phenotypes associated with the disease IgE responsiveness, atopic (OMIM:147050):
- Increased circulating IgE concentration (HP:0003212): An abnormally increased overall level of immunoglobulin E in blood. Evidence: TAS. (OMIM:147050)
- Asthma (HP:0002099): Asthma is characterized by increased responsiveness of the tracheobronchial tree to multiple stimuli, leading to narrowing of the air passages with resultant dyspnea, cough, and wheezing. Evidence: IEA. (OMIM:147050)
- Eczematoid dermatitis (HP:0000964): Eczema is a form of dermatitis that is characterized by scaly, pruritic, erythematous lesions located on flexural surfaces. Evidence: IEA. (OMIM:147050)
- Allergic rhinitis (HP:0003193): It is characterized by one or more symptoms including sneezing, itching, nasal congestion, and rhinorrhea. Evidence: TAS. (OMIM:147050)
- Autosomal dominant inheritance (HP:0000006): A mode of inheritance that is observed for traits related to a gene encoded on one of the autosomes (i.e., the human chromosomes 1-22) in which a trait manifests in heterozygotes. In the context of medical genetics, an autosomal dominant disorder is caused when a single copy of the mutant allele is present. Males and females are affected equally, and can both transmit the disorder with a risk of 50% for each child of inheriting the mutant allele. Evidence: IEA. (OMIM:147050)